- Congenital conductive hearing impairment (HP:0008591): A type of conductive deafness with congenital onset. Evidence: IEA. (OMIM:165680)
- Abnormality of the middle ear ossicles (HP:0004452): An abnormality of the middle-ear ossicles (three small bones called malleus, incus, and stapes) that are contained within the middle ear and serve to transmit sounds from the air to the fluid-filled labyrinth (cochlea). Evidence: IEA. (OMIM:165680)
- Autosomal dominant inheritance (HP:0000006): A mode of inheritance that is observed for traits related to a gene encoded on one of the autosomes (i.e., the human chromosomes 1-22) in which a trait manifests in heterozygotes. In the context of medical genetics, an autosomal dominant disorder is caused when a single copy of the mutant allele is present. Males and females are affected equally, and can both transmit the disorder with a risk of 50% for each child of inheriting the mutant allele. Evidence: IEA. (OMIM:165680)
These phenotypes are associated with the disease ossicular malformations, familial (OMIM:165680).